- Secondary amenorrhea (HP:0000869, a Human Phenotype Ontology term). Evidence: PCS. Frequency: 6/6. (PMID:26218421)
- Young adult onset (HP:0011462, a Human Phenotype Ontology term): Onset of disease at the age of between 16 and 40 years. Evidence: PCS. Frequency: 6/6. (PMID:26218421)
- Elevated circulating follicle stimulating hormone level (HP:0008232, a Human Phenotype Ontology term): An elevated concentration of follicle-stimulating hormone in the blood. Evidence: PCS. (PMID:26218421)
- Oligomenorrhea (HP:0000876, a Human Phenotype Ontology term): Infrequent menses (less than 6 per year or more than 35 days between cycles). Evidence: PCS. (PMID:26218421)
- Autosomal dominant inheritance (HP:0000006, a Human Phenotype Ontology term): A mode of inheritance that is observed for traits related to a gene encoded on one of the autosomes (i.e., the human chromosomes 1-22) in which a trait manifests in heterozygotes. In the context of medical genetics, an autosomal dominant disorder is caused when a single copy of the mutant allele is present. Males and females are affected equally, and can both transmit the disorder with a risk of 50% for each child of inheriting the mutant allele. Evidence: PCS. (PMID:26218421)
These phenotypes are associated with the disease premature ovarian failure 11 (OMIM:616946, an entry in Online Mendelian Inheritance in Man).